- Seborrheic dermatitis (HP:0001051): Seborrheic dermatitis is a form of eczema which is closely related to dandruff. It causes dry or greasy peeling of the scalp, eyebrows, and face, and sometimes trunk. Evidence: TAS. Frequency: Very frequent (HP:0040281). (ORPHA:314)
- Failure to thrive (HP:0001508): Failure to thrive (FTT) refers to a child whose physical growth is substantially below the norm. Evidence: TAS. Frequency: Very frequent (HP:0040281). (ORPHA:314)
- Diarrhea (HP:0002014): Abnormally increased frequency (usually defined as three or more) loose or watery bowel movements a day. Evidence: TAS. Frequency: Very frequent (HP:0040281). (ORPHA:314)
- Abnormality of immune system physiology (HP:0010978): A functional abnormality of the immune system. Evidence: TAS. Frequency: Very frequent (HP:0040281). (ORPHA:314)
These phenotypes are associated with the disease Erythroderma desquamativum (ORPHA:314).